Phenotypes associated with the disease microphthalmia, isolated, with corectopia (OMIM:156900):
- Ectopia pupillae (HP:0009918): A malposition of the pupil owing to a developmental defect of the iris. Evidence: IEA. (OMIM:156900)
- Microphthalmia (HP:0000568): A developmental anomaly characterized by abnormal smallness of one or both eyes. Evidence: IEA. (OMIM:156900)
- Autosomal dominant inheritance (HP:0000006): A mode of inheritance that is observed for traits related to a gene encoded on one of the autosomes (i.e., the human chromosomes 1-22) in which a trait manifests in heterozygotes. In the context of medical genetics, an autosomal dominant disorder is caused when a single copy of the mutant allele is present. Males and females are affected equally, and can both transmit the disorder with a risk of 50% for each child of inheriting the mutant allele. Evidence: IEA. (OMIM:156900)
- Myopia (HP:0000545): An abnormality of refraction characterized by the ability to see objects nearby clearly, while objects in the distance appear blurry. Evidence: IEA. (OMIM:156900)